- Cervical spondylosis (HP:0008480): Arthrosis, i.e., of degenerative joint disease, affecting the cervical vertebral column. Evidence: IEA. (OMIM:184300)
- Spondylolisthesis (HP:0003302): Complete bilateral fractures of the pars interarticularis resulting in the anterior slippage of the vertebra. Evidence: IEA. (OMIM:184300)
- Spina bifida occulta (HP:0003298): The closed form of spina bifida with incomplete closure of a vertebral body with intact overlying skin. Evidence: IEA. (OMIM:184300)
- Osteoarthritis (HP:0002758): Degeneration (wear and tear) of articular cartilage, i.e., of the joint surface. Joint degeneration may be accompanied by osteophytes (bone overgrowth), narrowing of the joint space, regions of sclerosis at the joint surface, or joint deformity. Evidence: IEA. (OMIM:184300)
- Autosomal dominant inheritance (HP:0000006): A mode of inheritance that is observed for traits related to a gene encoded on one of the autosomes (i.e., the human chromosomes 1-22) in which a trait manifests in heterozygotes. In the context of medical genetics, an autosomal dominant disorder is caused when a single copy of the mutant allele is present. Males and females are affected equally, and can both transmit the disorder with a risk of 50% for each child of inheriting the mutant allele. Evidence: IEA. (OMIM:184300)
- Spondylolysis (HP:0003304): Spondylolysis is an osseous defect of the pars interarticularis, thought to be a developmental or acquired stress fracture secondary to chronic low-grade trauma. Evidence: IEA. (OMIM:184300)
These phenotypes are associated with the disease spondylosis, cervical (OMIM:184300).